Phenotypes associated with the disease spastic paraplegia, optic atrophy, and dementia (OMIM:182830):
- Constriction of peripheral visual field (HP:0001133): An absolute or relative decrease in retinal sensitivity extending from edge (periphery) of the visual field in a concentric pattern. The visual field is the area that is perceived simultaneously by a fixating eye. Evidence: IEA. (OMIM:182830)
- Dementia (HP:0000726): A loss of global cognitive ability of sufficient amount to interfere with normal social or occupational function. Dementia represents a loss of previously present cognitive abilities, generally in adults, and can affect memory, thinking, language, judgment, and behavior. Evidence: IEA. (OMIM:182830)
- Optic atrophy (HP:0000648): Atrophy of the optic nerve. Optic atrophy results from the death of the retinal ganglion cell axons that comprise the optic nerve and manifesting as a pale optic nerve on fundoscopy. Evidence: IEA. (OMIM:182830)
- Optic disc pallor (HP:0000543): A pale yellow discoloration of the optic disc (the area of the optic nerve head in the retina). The optic disc normally has a pinkish hue with a central yellowish depression. Evidence: IEA. (OMIM:182830)
- Spastic paraplegia (HP:0001258): Complete loss of the ability to move the lower limbs accompanied by spasticity of the lower limbs. Evidence: IEA. (OMIM:182830)
- Autosomal dominant inheritance (HP:0000006): A mode of inheritance that is observed for traits related to a gene encoded on one of the autosomes (i.e., the human chromosomes 1-22) in which a trait manifests in heterozygotes. In the context of medical genetics, an autosomal dominant disorder is caused when a single copy of the mutant allele is present. Males and females are affected equally, and can both transmit the disorder with a risk of 50% for each child of inheriting the mutant allele. Evidence: IEA. (OMIM:182830)